- Sensorineural hearing impairment (HP:0000407): A type of hearing impairment in one or both ears related to an abnormal functionality of the cochlear nerve. Evidence: TAS. (OMIM:609706)
- Autosomal recessive inheritance (HP:0000007): A mode of inheritance that is observed for traits related to a gene encoded on one of the autosomes (i.e., the human chromosomes 1-22) in which a trait manifests in individuals with two pathogenic alleles, either homozygotes (two copies of the same mutant allele) or compound heterozygotes (whereby each copy of a gene has a distinct mutant allele). Evidence: TAS. (OMIM:609706)
These phenotypes are associated with the disease autosomal recessive nonsyndromic hearing loss 53 (OMIM:609706).